Phenotypes associated with the disease Behçet disease (ORPHA:117, an Orphanet rare-disease identifier):
- Malabsorption (HP:0002024, a Human Phenotype Ontology term): Impaired ability to absorb one or more nutrients from the intestine. Evidence: TAS. Frequency: Occasional (HP:0040283, a Human Phenotype Ontology term). (ORPHA:117)
- Anorexia (HP:0002039, a Human Phenotype Ontology term): Lack of desire to eat (loss of appetite). Evidence: TAS. Frequency: Occasional (HP:0040283, a Human Phenotype Ontology term). (ORPHA:117)
- Pleuritis (HP:0002102, a Human Phenotype Ontology term): Inflammation of the pleura. Evidence: TAS. Frequency: Occasional (HP:0040283, a Human Phenotype Ontology term). (ORPHA:117)
- Hemoptysis (HP:0002105, a Human Phenotype Ontology term): Coughing up (expectoration) of blood or blood-streaked sputum from the larynx, trachea, bronchi, or lungs. Evidence: TAS. Frequency: Occasional (HP:0040283, a Human Phenotype Ontology term). (ORPHA:117)
- Pulmonary infiltrates (HP:0002113, a Human Phenotype Ontology term). Evidence: TAS. Frequency: Occasional (HP:0040283, a Human Phenotype Ontology term). (ORPHA:117)
- Pleural effusion (HP:0002202, a Human Phenotype Ontology term): The presence of an excessive amount of fluid in the pleural cavity. Evidence: TAS. Frequency: Occasional (HP:0040283, a Human Phenotype Ontology term). (ORPHA:117)
- Pulmonary embolism (HP:0002204, a Human Phenotype Ontology term): An embolus (that is, an abnormal particle circulating in the blood) located in the pulmonary artery and thereby blocking blood circulation to the lung. Usually the embolus is a blood clot that has developed in an extremity (for instance, a deep venous thrombosis), detached, and traveled through the circulation before becoming trapped in the pulmonary artery. Evidence: TAS. Frequency: Occasional (HP:0040283, a Human Phenotype Ontology term). (ORPHA:117)
- Vertigo (HP:0002321, a Human Phenotype Ontology term): An abnormal sensation of spinning while the body is actually stationary. Evidence: TAS. Frequency: Occasional (HP:0040283, a Human Phenotype Ontology term). (ORPHA:117)
- Memory impairment (HP:0002354, a Human Phenotype Ontology term): An impairment of memory as manifested by a reduced ability to remember things such as dates and names, and increased forgetfulness. Evidence: TAS. Frequency: Occasional (HP:0040283, a Human Phenotype Ontology term). (ORPHA:117)
- Developmental regression (HP:0002376, a Human Phenotype Ontology term): Loss of developmental skills, as manifested by loss of developmental milestones. Evidence: TAS. Frequency: Occasional (HP:0040283, a Human Phenotype Ontology term). (ORPHA:117)
- Infectious encephalitis (HP:0002383, a Human Phenotype Ontology term): A disorder of the brain caused by an infectious agent that presents with fever, headache, and an altered level of consciousness. There may also be focal or multifocal neurologic deficits, and focal or generalized seizure activity. Evidence: TAS. Frequency: Occasional (HP:0040283, a Human Phenotype Ontology term). (ORPHA:117)
- Increased intracranial pressure (HP:0002516, a Human Phenotype Ontology term): An increase of the pressure inside the cranium (skull) and thereby in the brain tissue and cerebrospinal fluid. Evidence: TAS. Frequency: Occasional (HP:0040283, a Human Phenotype Ontology term). (ORPHA:117)
- Cerebral ischemia (HP:0002637, a Human Phenotype Ontology term): Restriction of arterial blood supply to the brain associated with insufficient oxygenation to support the metabolic requirements of the tissue. Evidence: TAS. Frequency: Occasional (HP:0040283, a Human Phenotype Ontology term). (ORPHA:117)
- Lymphadenopathy (HP:0002716, a Human Phenotype Ontology term): Enlargement (swelling) of a lymph node. Evidence: TAS. Frequency: Occasional (HP:0040283, a Human Phenotype Ontology term). (ORPHA:117)
- Paresthesia (HP:0003401, a Human Phenotype Ontology term): Abnormal sensations such as tingling, pricking, or numbness of the skin with no apparent physical cause. Evidence: TAS. Frequency: Occasional (HP:0040283, a Human Phenotype Ontology term). (ORPHA:117)
- Arterial thrombosis (HP:0004420, a Human Phenotype Ontology term): The formation of a blood clot inside an artery. Evidence: TAS. Frequency: Occasional (HP:0040283, a Human Phenotype Ontology term). (ORPHA:117)
- Cranial nerve paralysis (HP:0006824, a Human Phenotype Ontology term). Evidence: TAS. Frequency: Occasional (HP:0040283, a Human Phenotype Ontology term). (ORPHA:117)
- Abnormal pyramidal sign (HP:0007256, a Human Phenotype Ontology term): Functional neurological abnormalities related to dysfunction of the pyramidal tract. Evidence: TAS. Frequency: Occasional (HP:0040283, a Human Phenotype Ontology term). (ORPHA:117)
- Avascular necrosis (HP:0010885, a Human Phenotype Ontology term): A disease where there is cellular death (necrosis) of bone components due to interruption of the blood supply. Evidence: TAS. Frequency: Occasional (HP:0040283, a Human Phenotype Ontology term). (ORPHA:117)
- Myocarditis (HP:0012819, a Human Phenotype Ontology term): Inflammation of the myocardium. Evidence: TAS. Frequency: Occasional (HP:0040283, a Human Phenotype Ontology term). (ORPHA:117)
- Non-infectious meningitis (HP:0033430, a Human Phenotype Ontology term): Inflammation of the layers of tissue that cover the brain and spinal cord (meninges) and of the fluid-filled space between the meninges (subarachnoid space) when it is caused by disorders that are not infections or by drugs or vaccines. Evidence: TAS. Frequency: Occasional (HP:0040283, a Human Phenotype Ontology term). (ORPHA:117)
- Oral ulcer (HP:0000155, a Human Phenotype Ontology term): Erosion of the mucous mebrane of the mouth with local excavation of the surface, resulting from the sloughing of inflammatory necrotic tissue. Evidence: TAS. Frequency: Very frequent (HP:0040281, a Human Phenotype Ontology term). (ORPHA:117)
- Photophobia (HP:0000613, a Human Phenotype Ontology term): Excessive sensitivity to light with the sensation of discomfort or pain in the eyes due to exposure to bright light. Evidence: TAS. Frequency: Very frequent (HP:0040281, a Human Phenotype Ontology term). (ORPHA:117)
- Meningitis (HP:0001287, a Human Phenotype Ontology term): Inflammation of the meninges. Evidence: TAS. Frequency: Very frequent (HP:0040281, a Human Phenotype Ontology term). (ORPHA:117)
- Arthritis (HP:0001369, a Human Phenotype Ontology term): Inflammation of a joint. Evidence: TAS. Frequency: Very frequent (HP:0040281, a Human Phenotype Ontology term). (ORPHA:117)
- Subcutaneous nodule (HP:0001482, a Human Phenotype Ontology term): Slightly elevated lesions on or in the skin with a diameter of over 5 mm. Evidence: TAS. Frequency: Very frequent (HP:0040281, a Human Phenotype Ontology term). (ORPHA:117)
- Fever (HP:0001945, a Human Phenotype Ontology term): Body temperature elevated above the normal range. Evidence: TAS. Frequency: Very frequent (HP:0040281, a Human Phenotype Ontology term). (ORPHA:117)
- Nausea and vomiting (HP:0002017, a Human Phenotype Ontology term): Nausea is a commonly encountered symptom that has been defined as an unpleasant painless subjective feeling that one will imminently vomit. Vomiting has been defined as the forceful expulsion of the contents of the stomach, duodenum, or jejunum through the oral cavity. While nausea and vomiting are often thought to exist on a temporal continuum, this is not always the case. There are situations when severe nausea may be present without emesis and less frequently, when emesis may be present without preceding nausea. Evidence: TAS. Frequency: Very frequent (HP:0040281, a Human Phenotype Ontology term). (ORPHA:117)
- Migraine (HP:0002076, a Human Phenotype Ontology term): Migraine is a chronic neurological disorder characterized by episodic attacks of headache and associated symptoms. Evidence: TAS. Frequency: Very frequent (HP:0040281, a Human Phenotype Ontology term). (ORPHA:117)
- Vasculitis (HP:0002633, a Human Phenotype Ontology term): Inflammation of blood vessel. Evidence: TAS. Frequency: Very frequent (HP:0040281, a Human Phenotype Ontology term). (ORPHA:117)
- Myalgia (HP:0003326, a Human Phenotype Ontology term): Pain in muscle. Evidence: TAS. Frequency: Very frequent (HP:0040281, a Human Phenotype Ontology term). (ORPHA:117)
- Recurrent aphthous stomatitis (HP:0011107, a Human Phenotype Ontology term): Recurrent episodes of ulceration of the oral mucosa, typically presenting as painful, sharply circumscribed fibrin-covered mucosal defects with a hyperemic border. Evidence: TAS. Frequency: Very frequent (HP:0040281, a Human Phenotype Ontology term). (ORPHA:117)
- Fatigue (HP:0012378, a Human Phenotype Ontology term): A subjective feeling of tiredness characterized by a lack of energy and motivation. Evidence: TAS. Frequency: Very frequent (HP:0040281, a Human Phenotype Ontology term). (ORPHA:117)
- Orchitis (HP:0100796, a Human Phenotype Ontology term): Testicular inflammation. Evidence: TAS. Frequency: Very frequent (HP:0040281, a Human Phenotype Ontology term). (ORPHA:117)
- Papule (HP:0200034, a Human Phenotype Ontology term): A circumscribed, solid elevation of skin with no visible fluid, varying in size from a pinhead to less than 10mm in diameter at the widest point. Evidence: TAS. Frequency: Very frequent (HP:0040281, a Human Phenotype Ontology term). (ORPHA:117)
- Acne (HP:0001061, a Human Phenotype Ontology term): A skin condition in which there is an increase in sebum secretion by the pilosebaceous apparatus associated with open comedones (blackheads), closed comedones (whiteheads), and pustular nodules (papules, pustules, and cysts). Evidence: TAS. Frequency: Frequent (HP:0040282, a Human Phenotype Ontology term). (ORPHA:117)
- Hemiparesis (HP:0001269, a Human Phenotype Ontology term): Loss of strength in the arm, leg, and sometimes face on one side of the body. Hemiplegia refers to a complete loss of strength, whereas hemiparesis refers to an incomplete loss of strength. Evidence: TAS. Frequency: Frequent (HP:0040282, a Human Phenotype Ontology term). (ORPHA:117)
- Gait disturbance (HP:0001288, a Human Phenotype Ontology term): The term gait disturbance can refer to any disruption of the ability to walk. Evidence: TAS. Frequency: Frequent (HP:0040282, a Human Phenotype Ontology term). (ORPHA:117)
- Confusion (HP:0001289, a Human Phenotype Ontology term): Lack of clarity and coherence of thought, perception, understanding, or action. Evidence: TAS. Frequency: Frequent (HP:0040282, a Human Phenotype Ontology term). (ORPHA:117)
- Abdominal pain (HP:0002027, a Human Phenotype Ontology term): An unpleasant sensation characterized by physical discomfort (such as pricking, throbbing, or aching) and perceived to originate in the abdomen. Evidence: TAS. Frequency: Frequent (HP:0040282, a Human Phenotype Ontology term). (ORPHA:117)
- Gastrointestinal hemorrhage (HP:0002239, a Human Phenotype Ontology term): Hemorrhage affecting the gastrointestinal tract. Evidence: TAS. Frequency: Frequent (HP:0040282, a Human Phenotype Ontology term). (ORPHA:117)
- Headache (HP:0002315, a Human Phenotype Ontology term): Cephalgia, or pain sensed in various parts of the head, not confined to the area of distribution of any nerve. Evidence: TAS. Frequency: Frequent (HP:0040282, a Human Phenotype Ontology term). (ORPHA:117)
- Superficial thrombophlebitis (HP:0002638, a Human Phenotype Ontology term): Inflammation of a superficial vein associated with venous thrombosis (blood clot formation within the vein). Evidence: TAS. Frequency: Frequent (HP:0040282, a Human Phenotype Ontology term). (ORPHA:117)
- Arthralgia (HP:0002829, a Human Phenotype Ontology term): Joint pain. Evidence: TAS. Frequency: Frequent (HP:0040282, a Human Phenotype Ontology term). (ORPHA:117)
- Genital ulcers (HP:0003249, a Human Phenotype Ontology term). Evidence: TAS. Frequency: Frequent (HP:0040282, a Human Phenotype Ontology term). (ORPHA:117)
- Elevated erythrocyte sedimentation rate (HP:0003565, a Human Phenotype Ontology term): An increased erythrocyte sedimentation rate (ESR). The ESR is a test that measures the distance that erythrocytes have fallen after one hour in a vertical column of anticoagulated blood under the influence of gravity. The ESR is a nonspecific finding. An elevation may indicate inflammation or may be caused by any condition that elevates fibrinogen. Evidence: TAS. Frequency: Frequent (HP:0040282, a Human Phenotype Ontology term). (ORPHA:117)
- Venous thrombosis (HP:0004936, a Human Phenotype Ontology term): Formation of a blood clot (thrombus) inside a vein, causing the obstruction of blood flow. Evidence: TAS. Frequency: Frequent (HP:0040282, a Human Phenotype Ontology term). (ORPHA:117)
- Nongranulomatous uveitis (HP:0007813, a Human Phenotype Ontology term): A form of uveitis that is not associated with the formation of granulomas. Evidence: TAS. Frequency: Frequent (HP:0040282, a Human Phenotype Ontology term). (ORPHA:117)
- Abnormal blistering of the skin (HP:0008066, a Human Phenotype Ontology term): The presence of one or more bullae on the skin, defined as fluid-filled blisters more than 5 mm in diameter with thin walls. Evidence: TAS. Frequency: Frequent (HP:0040282, a Human Phenotype Ontology term). (ORPHA:117)
- Elevated circulating C-reactive protein concentration (HP:0011227, a Human Phenotype Ontology term): The concentration of C-reactive protein in the blood circulation is above the upper limit of normal. Evidence: TAS. Frequency: Frequent (HP:0040282, a Human Phenotype Ontology term). (ORPHA:117)
- Panuveitis (HP:0012121, a Human Phenotype Ontology term): Inflammation of the uveal tract in which inflammation affects the anterior chamber, vitreous, retina or choroid. Evidence: TAS. Frequency: Frequent (HP:0040282, a Human Phenotype Ontology term). (ORPHA:117)
- Erythema nodosum (HP:0012219, a Human Phenotype Ontology term): An erythematous eruption commonly associated with drug reactions or infection and characterized by inflammatory nodules that are usually tender, multiple, and bilateral. Evidence: TAS. Frequency: Frequent (HP:0040282, a Human Phenotype Ontology term). (ORPHA:117)
- Increased inflammatory response (HP:0012649, a Human Phenotype Ontology term): A abnormal increase in the inflammatory response to injury or infection. Evidence: TAS. Frequency: Frequent (HP:0040282, a Human Phenotype Ontology term). (ORPHA:117)
- Positive pathergy test (HP:0025532, a Human Phenotype Ontology term): With the pathergy test, a small, sterile needle is inserted into the skin of the forearm. The site of injectionis circuled and observed after one and two days. If a small red bump or pustule at the site of needle insertion occurs, the pathergy test is considered to have a positive (abnormal) result. Evidence: TAS. Frequency: Frequent (HP:0040282, a Human Phenotype Ontology term). (ORPHA:117)
- Immunologic hypersensitivity (HP:0100326, a Human Phenotype Ontology term): Immunological states where the immune system produces harmful responses upon reexposure to sensitizing antigens. Evidence: TAS. Frequency: Frequent (HP:0040282, a Human Phenotype Ontology term). (ORPHA:117)
- Pustule (HP:0200039, a Human Phenotype Ontology term): A small elevation of the skin containing cloudy or purulent material usually consisting of necrotic inflammatory cells. Evidence: TAS. Frequency: Frequent (HP:0040282, a Human Phenotype Ontology term). (ORPHA:117)
- Epididymitis (HP:0000031, a Human Phenotype Ontology term): The presence of inflammation of the epididymis. Evidence: TAS. Frequency: Occasional (HP:0040283, a Human Phenotype Ontology term). (ORPHA:117)
- Renal insufficiency (HP:0000083, a Human Phenotype Ontology term): A reduction in the level of performance of the kidneys in areas of function comprising the concentration of urine, removal of wastes, the maintenance of electrolyte balance, homeostasis of blood pressure, and calcium metabolism. Evidence: TAS. Frequency: Occasional (HP:0040283, a Human Phenotype Ontology term). (ORPHA:117)
- Retinopathy (HP:0000488, a Human Phenotype Ontology term): Any noninflammatory disease of the retina. This nonspecific term is retained here because of its wide use in the literature, but if possible new annotations should indicate the precise type of retinal abnormality. Evidence: TAS. Frequency: Occasional (HP:0040283, a Human Phenotype Ontology term). (ORPHA:117)
- Cataract (HP:0000518, a Human Phenotype Ontology term): A cataract is an opacity or clouding that develops in the crystalline lens of the eye or in its capsule. Evidence: TAS. Frequency: Occasional (HP:0040283, a Human Phenotype Ontology term). (ORPHA:117)
- Blindness (HP:0000618, a Human Phenotype Ontology term): Blindness is the condition of lacking visual perception defined as a profound reduction in visual perception. On the 6m visual acuity scale, blindness is defined as less than 3/60. On the 20ft visual acuity scale, blindness is defined as less than 20/400. On the decimal visual acuity scale, blindness is defined as less than 0.05. Blindness is typically characterized by a visual field of no greater than 10 degrees in radius around central fixation. Evidence: TAS. Frequency: Occasional (HP:0040283, a Human Phenotype Ontology term). (ORPHA:117)
- Atypical behavior (HP:0000708, a Human Phenotype Ontology term): Atypical behavior is an abnormality in a person's actions that can be controlled or modulated by the will of the individual. While abnormal behaviors can be difficult to control, they are distinct from other abnormal actions that cannot be affected by the individual's will. Evidence: TAS. Frequency: Occasional (HP:0040283, a Human Phenotype Ontology term). (ORPHA:117)
- Irritability (HP:0000737, a Human Phenotype Ontology term): An emotional state characterized by negative feelings of heightened frustration, annoyance, or feeling upset, often triggered by internal factors (e.g., fatigue, hunger, unfulfilled desires) or external factors (e.g., social or environmental challenges). Irritability may be unpredictable, and is accompanied by a lowered threshold for emotional reactivity and observable features (speech, facial expressions, or psychomotor activity). Evidence: TAS. Frequency: Occasional (HP:0040283, a Human Phenotype Ontology term). (ORPHA:117)
- Keratoconjunctivitis sicca (HP:0001097, a Human Phenotype Ontology term): Dryness of the eye related to deficiency of the tear film components (aqueous, mucin, or lipid), lid surface abnormalities, or epithelial abnormalities. Keratoconjunctivitis sicca often results in a scratchy or sandy sensation (foreign body sensation) in the eyes, and may also be associated with itching, inability to produce tears, photosensitivity, redness, pain, and difficulty in moving the eyelids. Evidence: TAS. Frequency: Occasional (HP:0040283, a Human Phenotype Ontology term). (ORPHA:117)
- Seizure (HP:0001250, a Human Phenotype Ontology term): A seizure is an intermittent abnormality of nervous system physiology characterized by a transient occurrence of signs and/or symptoms due to abnormal excessive or synchronous neuronal activity in the brain. Evidence: TAS. Frequency: Occasional (HP:0040283, a Human Phenotype Ontology term). (ORPHA:117)
- Ataxia (HP:0001251, a Human Phenotype Ontology term): Ataxia refers to impaired coordination of voluntary muscle movement. Cerebellar ataxia refers to ataxia due to dysfunction of the cerebellum. This causes a variety of elementary neurological deficits including asynergy (lack of coordination between muscles, limbs and joints), dysmetria (lack of ability to judge distances that can lead to under- or overshoot in grasping movements), and dysdiadochokinesia (inability to perform rapid movements requiring antagonizing muscle groups to be switched on and off repeatedly). Evidence: TAS. Frequency: Occasional (HP:0040283, a Human Phenotype Ontology term). (ORPHA:117)
- Hyperreflexia (HP:0001347, a Human Phenotype Ontology term): Hyperreflexia is the presence of hyperactive stretch reflexes of the muscles. Evidence: TAS. Frequency: Occasional (HP:0040283, a Human Phenotype Ontology term). (ORPHA:117)
- Abnormal myocardium morphology (HP:0001637, a Human Phenotype Ontology term): A structural anomaly of the muscle layer of the heart wall. Evidence: TAS. Frequency: Occasional (HP:0040283, a Human Phenotype Ontology term). (ORPHA:117)
- Mitral regurgitation (HP:0001653, a Human Phenotype Ontology term): An abnormality of the mitral valve characterized by insufficiency or incompetence of the mitral valve resulting in retrograde leaking of blood through the mitral valve upon ventricular contraction. Evidence: TAS. Frequency: Occasional (HP:0040283, a Human Phenotype Ontology term). (ORPHA:117)
- Myocardial infarction (HP:0001658, a Human Phenotype Ontology term): Necrosis of the myocardium caused by an obstruction of the blood supply to the heart and often associated with chest pain, shortness of breath, palpitations, and anxiety as well as characteristic EKG findings and elevation of serum markers including creatine kinase-MB fraction and troponin. Evidence: TAS. Frequency: Occasional (HP:0040283, a Human Phenotype Ontology term). (ORPHA:117)
- Aortic regurgitation (HP:0001659, a Human Phenotype Ontology term): An insufficiency of the aortic valve, leading to regurgitation (backward flow) of blood from the aorta into the left ventricle. Evidence: TAS. Frequency: Occasional (HP:0040283, a Human Phenotype Ontology term). (ORPHA:117)
- Pericarditis (HP:0001701, a Human Phenotype Ontology term): Inflammation of the sac-like covering around the heart (pericardium). Evidence: TAS. Frequency: Occasional (HP:0040283, a Human Phenotype Ontology term). (ORPHA:117)
- Pancreatitis (HP:0001733, a Human Phenotype Ontology term): The presence of inflammation in the pancreas. Evidence: TAS. Frequency: Occasional (HP:0040283, a Human Phenotype Ontology term). (ORPHA:117)
- Splenomegaly (HP:0001744, a Human Phenotype Ontology term): Abnormal increased size of the spleen. Evidence: TAS. Frequency: Occasional (HP:0040283, a Human Phenotype Ontology term). (ORPHA:117)
- Weight loss (HP:0001824, a Human Phenotype Ontology term): Reduction of total body weight. Evidence: TAS. Frequency: Occasional (HP:0040283, a Human Phenotype Ontology term). (ORPHA:117)
- Recurrent fever (HP:0001954, a Human Phenotype Ontology term): Periodic (episodic or recurrent) bouts of fever. Evidence: TAS. Frequency: Occasional (HP:0040283, a Human Phenotype Ontology term). (ORPHA:117)
- Endocarditis (HP:0100584, a Human Phenotype Ontology term): An inflammation of the endocardium, the inner layer of the heart, which usually involves the heart valves. Evidence: TAS. Frequency: Occasional (HP:0040283, a Human Phenotype Ontology term). (ORPHA:117)
- Myositis (HP:0100614, a Human Phenotype Ontology term): A general term for inflammation of the muscles without respect to the underlying cause. Evidence: TAS. Frequency: Occasional (HP:0040283, a Human Phenotype Ontology term). (ORPHA:117)
- Optic neuritis (HP:0100653, a Human Phenotype Ontology term): Inflammation of the optic nerve. Evidence: TAS. Frequency: Occasional (HP:0040283, a Human Phenotype Ontology term). (ORPHA:117)
- Retrobulbar optic neuritis (HP:0100654, a Human Phenotype Ontology term): Optic neuritis that occurs in the section of the optic nerve located behind the eyeball. Evidence: TAS. Frequency: Occasional (HP:0040283, a Human Phenotype Ontology term). (ORPHA:117)
- Gangrene (HP:0100758, a Human Phenotype Ontology term): A serious and potentially life-threatening condition that arises when a considerable mass of body tissue dies (necrosis). Evidence: TAS. Frequency: Occasional (HP:0040283, a Human Phenotype Ontology term). (ORPHA:117)
- Glomerulopathy (HP:0100820, a Human Phenotype Ontology term): Inflammatory or noninflammatory diseases affecting the glomeruli of the nephron. Evidence: TAS. Frequency: Occasional (HP:0040283, a Human Phenotype Ontology term). (ORPHA:117)
- AA amyloidosis (HP:4000041, a Human Phenotype Ontology term): Extracellular tissue deposition of fibrils that are composed of fragments of and/or intact serum amyloid A protein, a hepatic acute phase reactant. Evidence: TAS. Frequency: Occasional (HP:0040283, a Human Phenotype Ontology term). (ORPHA:117)
- Glomerulonephritis (HP:0000099, a Human Phenotype Ontology term): Inflammation of the renal glomeruli. Evidence: TAS. Frequency: Very rare (HP:0040284, a Human Phenotype Ontology term). (ORPHA:117)
- Diarrhea (HP:0002014, a Human Phenotype Ontology term): Abnormally increased frequency (usually defined as three or more) loose or watery bowel movements a day. Evidence: TAS. Frequency: Very rare (HP:0040284, a Human Phenotype Ontology term). (ORPHA:117)